Phenotypes associated with the disease Pfeiffer syndrome type 2 (ORPHA:93259):
- Cleft palate (HP:0000175): Cleft palate is a developmental defect of the palate resulting from a failure of fusion of the palatine processes and manifesting as a separation of the roof of the mouth (soft and hard palate). Evidence: TAS. Frequency: Occasional (HP:0040283). (ORPHA:93259)
- High palate (HP:0000218): Height of the palate more than 2 SD above the mean (objective) or palatal height at the level of the first permanent molar more than twice the height of the teeth (subjective). Evidence: TAS. Frequency: Very frequent (HP:0040281). (ORPHA:93259)
- Hydrocephalus (HP:0000238): Hydrocephalus is an active distension of the ventricular system of the brain resulting from inadequate passage of CSF from its point of production within the cerebral ventricles to its point of absorption into the systemic circulation. Evidence: TAS. Frequency: Frequent (HP:0040282). (ORPHA:93259)
- Malar flattening (HP:0000272): Underdevelopment of the malar prominence of the jugal bone (zygomatic bone in mammals), appreciated in profile, frontal view, and/or by palpation. Evidence: TAS. Frequency: Very frequent (HP:0040281). (ORPHA:93259)
- Hypertelorism (HP:0000316): Interpupillary distance more than 2 SD above the mean (alternatively, the appearance of an increased interpupillary distance or widely spaced eyes). Evidence: TAS. Frequency: Very frequent (HP:0040281). (ORPHA:93259)
- High forehead (HP:0000348): An abnormally increased height of the forehead. Evidence: TAS. Frequency: Very frequent (HP:0040281). (ORPHA:93259)
- Low-set ears (HP:0000369): Upper insertion of the ear to the scalp below an imaginary horizontal line drawn between the inner canthi of the eye and extending posteriorly to the ear. Evidence: TAS. Frequency: Frequent (HP:0040282). (ORPHA:93259)
- Atresia of the external auditory canal (HP:0000413): Absence or failure to form of the external auditory canal. Evidence: TAS. Frequency: Frequent (HP:0040282). (ORPHA:93259)
- Choanal atresia (HP:0000453): Absence or abnormal closure of the choana (the posterior nasal aperture). Most embryologists believe that posterior choanal atresia results from a failure of rupture between the 35th and 38th day of fetal life of the partition which separates the bucconasal or buccopharyngeal membranes. The resultant choanal atresia may be unilateral or bilateral, bony or membranous, complete or incomplete. In over 90 per cent of cases the obstruction is bony, while in the remainder it is membranous. The bony type of atresia is commonly located 1-2 mm. anterior to the posterior edge of the hard palate, and the osseous septum varies in thickness from 1 to 10 mm. In the membranous form of choanal atresia the obstruction usually occurs further posteriorly. In approximately one third of cases the atresia is bilateral. Evidence: TAS. Frequency: Frequent (HP:0040282). (ORPHA:93259)
- Proptosis (HP:0000520): An eye that is protruding anterior to the plane of the face to a greater extent than is typical. Evidence: TAS. Frequency: Very frequent (HP:0040281). (ORPHA:93259)
- Visual loss (HP:0000572): Loss of visual acuity (implying that vision was better at a certain time point in life). Otherwise the term reduced visual acuity should be used (or a subclass of that). Evidence: TAS. Frequency: Occasional (HP:0040283). (ORPHA:93259)
- Intellectual disability (HP:0001249): The term intellectual disability or intellectual developmental disorder is used to describe significantly sub-average intellectual and adaptive functioning based on clinical assessment and as measured by individually administered, appropriately normed, standardized and validated tests of intellectual functioning and adaptive behavior, with onset during the developmental period from infancy through adolescence. Evidence: TAS. Frequency: Frequent (HP:0040282). (ORPHA:93259)
- Seizure (HP:0001250): A seizure is an intermittent abnormality of nervous system physiology characterized by a transient occurrence of signs and/or symptoms due to abnormal excessive or synchronous neuronal activity in the brain. Evidence: TAS. Frequency: Frequent (HP:0040282). (ORPHA:93259)
- Global developmental delay (HP:0001263): A delay in the achievement of motor or mental milestones in the domains of development of a child, including motor skills, speech and language, cognitive skills, and social and emotional skills. This term should only be used to describe children younger than five years of age. Evidence: TAS. Frequency: Frequent (HP:0040282). (ORPHA:93259)
- Limitation of joint mobility (HP:0001376): A reduction in the freedom of movement of one or more joints. Evidence: TAS. Frequency: Very frequent (HP:0040281). (ORPHA:93259)
- Laryngomalacia (HP:0001601): Laryngomalacia is a congenital abnormality of the laryngeal cartilage in which the cartilage is floppy and prolapses over the larynx during inspiration. Evidence: TAS. Frequency: Frequent (HP:0040282). (ORPHA:93259)
- Toe syndactyly (HP:0001770): Webbing or fusion of the toes, involving soft parts only or including bone structure. Bony fusions are referred to as "bony" Syndactyly if the fusion occurs in a radio-ulnar axis. Fusions of bones of the toes in a proximo-distal axis are referred to as "Symphalangism". Evidence: TAS. Frequency: Frequent (HP:0040282). (ORPHA:93259)
- Short foot (HP:0001773): A measured foot length that is more than 2 SD below the mean for a newborn of 27 - 41 weeks gestation, or foot that is less than the 3rd centile for individuals from birth to 16 years of age (objective). Alternatively, a foot that appears disproportionately short (subjective). Evidence: TAS. Frequency: Frequent (HP:0040282). (ORPHA:93259)
- Anal atresia (HP:0002023): Congenital absence of the anus, i.e., the opening at the bottom end of the intestinal tract. Evidence: TAS. Frequency: Occasional (HP:0040283). (ORPHA:93259)
- Respiratory distress (HP:0002098): Respiratory distress is objectively observable as the physical or emotional consequences from the experience of dyspnea. The physical presentation of respiratory distress is generally referred to as labored breathing, while the sensation of respiratory distress is called shortness of breath or dyspnea. Evidence: TAS. Frequency: Very frequent (HP:0040281). (ORPHA:93259)
- Chiari malformation (HP:0002308): Chiari malformation consists of a downward displacement of the cerebellar tonsils and the medulla through the foramen magnum, sometimes causing hydrocephalus as a result of obstruction of CSF outflow. Evidence: TAS. Frequency: Very frequent (HP:0040281). (ORPHA:93259)
- Aqueductal stenosis (HP:0002410): Stenosis of the cerebral aqueduct (also known as the mesencephalic duct, aqueductus mesencephali, or aqueduct of Sylvius), which connects the third cerebral ventricle in the diencephalon to the fourth ventricle, which is between the pons and cerebellum. Evidence: TAS. Frequency: Frequent (HP:0040282). (ORPHA:93259)
- Increased intracranial pressure (HP:0002516): An increase of the pressure inside the cranium (skull) and thereby in the brain tissue and cerebrospinal fluid. Evidence: TAS. Frequency: Occasional (HP:0040283). (ORPHA:93259)
- Intestinal malrotation (HP:0002566): An abnormality of the intestinal rotation and fixation that normally occurs during the development of the gut. This can lead to volvulus, or twisting of the intestine that causes obstruction and necrosis. Evidence: TAS. Frequency: Occasional (HP:0040283). (ORPHA:93259)
- Cloverleaf skull (HP:0002676): Trilobar skull configuration when viewed from the front or behind. Evidence: TAS. Frequency: Very frequent (HP:0040281). (ORPHA:93259)
- Tracheomalacia (HP:0002779). Evidence: TAS. Frequency: Frequent (HP:0040282). (ORPHA:93259)
- Short nose (HP:0003196): Distance from nasion to subnasale more than two standard deviations below the mean, or alternatively, an apparently decreased length from the nasal root to the nasal tip. Evidence: TAS. Frequency: Very frequent (HP:0040281). (ORPHA:93259)
- Depressed nasal bridge (HP:0005280): Posterior positioning of the nasal root in relation to the overall facial profile for age. Evidence: TAS. Frequency: Very frequent (HP:0040281). (ORPHA:93259)
- Finger syndactyly (HP:0006101): Webbing or fusion of the fingers, involving soft parts only or including bone structure. Bony fusions are referred to as "bony" Syndactyly if the fusion occurs in a radio-ulnar axis. Fusions of bones of the fingers in a proximo-distal axis are referred to as "Symphalangism". Evidence: TAS. Frequency: Frequent (HP:0040282). (ORPHA:93259)
- Hallux varus (HP:0008080): Medial deviation of the great toe owing to a deformity of the great toe joint causing the hallux to deviate medially. Evidence: TAS. Frequency: Very frequent (HP:0040281). (ORPHA:93259)
- Deviation of the thumb (HP:0009603): Displacement of the thumb from its normal position. Evidence: TAS. Frequency: Very frequent (HP:0040281). (ORPHA:93259)
- Broad hallux phalanx (HP:0010059): An increase in width in one or more phalanges of the big toe. Evidence: TAS. Frequency: Very frequent (HP:0040281). (ORPHA:93259)
- Short hallux (HP:0010109): Underdevelopment (hypoplasia) of the big toe. Evidence: TAS. Frequency: Very frequent (HP:0040281). (ORPHA:93259)
- Broad thumb (HP:0011304): Increased thumb width without increased dorso-ventral dimension. Evidence: TAS. Frequency: Very frequent (HP:0040281). (ORPHA:93259)
- Small hand (HP:0200055): Disproportionately small hand. Evidence: TAS. Frequency: Frequent (HP:0040282). (ORPHA:93259)